Phenotypes associated with the disease cataract 7 (OMIM:115660, an entry in Online Mendelian Inheritance in Man):
- Visual loss (HP:0000572, a Human Phenotype Ontology term): Loss of visual acuity (implying that vision was better at a certain time point in life). Otherwise the term reduced visual acuity should be used (or a subclass of that). Evidence: IEA. (OMIM:115660)
- Developmental cataract (HP:0000519, a Human Phenotype Ontology term): A cataract that occurs congenitally as the result of a developmental defect, in contrast to the majority of cataracts that occur in adulthood as the result of degenerative changes of the lens. Evidence: TAS. (OMIM:115660)
- Mildly reduced visual acuity (HP:0032037, a Human Phenotype Ontology term): Mild reduction of the ability to see. On the 6m visual acuity scale, mild reduction is defined as less than 6/12 but at least 6/18. On the 20ft visual acuity scale, mild reduction is defined as less than 20/40 but at least 20/70. On the decimal visual acuity scale, mild reduction is defined as less than 0.5 but at least 0.3. Evidence: IEA. (OMIM:115660)
- Autosomal dominant inheritance (HP:0000006, a Human Phenotype Ontology term): A mode of inheritance that is observed for traits related to a gene encoded on one of the autosomes (i.e., the human chromosomes 1-22) in which a trait manifests in heterozygotes. In the context of medical genetics, an autosomal dominant disorder is caused when a single copy of the mutant allele is present. Males and females are affected equally, and can both transmit the disorder with a risk of 50% for each child of inheriting the mutant allele. Evidence: IEA. (OMIM:115660)